Phenotypes associated with the disease Cranioectodermal dysplasia (ORPHA:1515):
- Joint hypermobility (HP:0001382): The capability that a joint (or a group of joints) has to move, passively and/or actively, beyond normal limits along physiological axes. Evidence: TAS. Frequency: Frequent (HP:0040282). (ORPHA:1515)
- Rhizomelia (HP:0008905): Disproportionate shortening of the proximal segment of limbs (i.e. the femur and humerus). Evidence: TAS. Frequency: Very frequent (HP:0040281). (ORPHA:1515)
- Short distal phalanx of finger (HP:0009882): Short distance from the end of the finger to the most distal interphalangeal crease or the distal interphalangeal joint flexion point. That is, hypoplasia of one or more of the distal phalanx of finger. Evidence: TAS. Frequency: Very frequent (HP:0040281). (ORPHA:1515)
- Everted lower lip vermilion (HP:0000232): An abnormal configuration of the lower lip such that it is turned outward i.e., everted, with the Inner aspect of the lower lip vermilion (normally opposing the teeth) being visible in a frontal view. Evidence: TAS. Frequency: Frequent (HP:0040282). (ORPHA:1515)
- Anteverted nares (HP:0000463): Anteriorly-facing nostrils viewed with the head in the Frankfurt horizontal and the eyes of the observer level with the eyes of the subject. This gives the appearance of an upturned nose (upturned nasal tip). Evidence: TAS. Frequency: Frequent (HP:0040282). (ORPHA:1515)
- Hypotelorism (HP:0000601): Interpupillary distance less than 2 SD below the mean (alternatively, the appearance of an decreased interpupillary distance or closely spaced eyes). Evidence: TAS. Frequency: Frequent (HP:0040282). (ORPHA:1515)
- Hypodontia (HP:0000668): The absence of five or less teeth from the normal series by a failure to develop. Evidence: TAS. Frequency: Frequent (HP:0040282). (ORPHA:1515)
- Pectus excavatum (HP:0000767): A defect of the chest wall characterized by a depression of the sternum, giving the chest ("pectus") a caved-in ("excavatum") appearance. Evidence: TAS. Frequency: Frequent (HP:0040282). (ORPHA:1515)
- Craniosynostosis (HP:0001363): Craniosynostosis refers to the premature closure of the cranial sutures. Primary craniosynostosis refers to the closure of one or more sutures due to abnormalities in skull development, and secondary craniosynostosis results from failure of brain growth. Evidence: TAS. Frequency: Frequent (HP:0040282). (ORPHA:1515)
- Finger syndactyly (HP:0006101): Webbing or fusion of the fingers, involving soft parts only or including bone structure. Bony fusions are referred to as "bony" Syndactyly if the fusion occurs in a radio-ulnar axis. Fusions of bones of the fingers in a proximo-distal axis are referred to as "Symphalangism". Evidence: TAS. Frequency: Frequent (HP:0040282). (ORPHA:1515)
- Myopia (HP:0000545): An abnormality of refraction characterized by the ability to see objects nearby clearly, while objects in the distance appear blurry. Evidence: TAS. Frequency: Occasional (HP:0040283). (ORPHA:1515)
- Nystagmus (HP:0000639): Rhythmic, involuntary oscillations of one or both eyes related to abnormality in fixation, conjugate gaze, or vestibular mechanisms. Evidence: TAS. Frequency: Occasional (HP:0040283). (ORPHA:1515)
- Taurodontia (HP:0000679): Increased volume of dental pulp of permanent molar characterized by a crown body-root ratio equal or larger than 1:1 or an elongated pulp chambers and apical displacement of the bifurcation or trifurcation of the roots. Evidence: TAS. Frequency: Occasional (HP:0040283). (ORPHA:1515)
- Abnormal dental enamel morphology (HP:0000682): An abnormality of the dental enamel. Evidence: TAS. Frequency: Occasional (HP:0040283). (ORPHA:1515)
- Clinodactyly of the 5th finger (HP:0004209): Clinodactyly refers to a bending or curvature of the fifth finger in the radial direction (i.e., towards the 4th finger). Evidence: TAS. Frequency: Occasional (HP:0040283). (ORPHA:1515)
- High hypermetropia (HP:0008499): A severe form of hypermetropia with over +5.00 diopters. Evidence: TAS. Frequency: Occasional (HP:0040283). (ORPHA:1515)
- Abnormality of the dentition (HP:0000164): Any abnormality of the teeth. Evidence: TAS. Frequency: Very frequent (HP:0040281). (ORPHA:1515)
- Dolichocephaly (HP:0000268): An abnormality of skull shape characterized by a increased anterior-posterior diameter, i.e., an increased antero-posterior dimension of the skull. Cephalic index less than 76%. Alternatively, an apparently increased antero-posterior length of the head compared to width. Often due to premature closure of the sagittal suture. Evidence: TAS. Frequency: Very frequent (HP:0040281). (ORPHA:1515)
- Prominent occiput (HP:0000269): Increased convexity of the occiput (posterior part of the skull). Evidence: TAS. Frequency: Very frequent (HP:0040281). (ORPHA:1515)
- Epicanthus (HP:0000286): A fold of skin starting above the medial aspect of the upper eyelid and arching downward to cover, pass in front of and lateral to the medial canthus. Evidence: TAS. Frequency: Very frequent (HP:0040281). (ORPHA:1515)
- Microdontia (HP:0000691): Decreased size of the teeth, which can be defined as a mesiodistal tooth diameter (width) more than 2 SD below mean. Alternatively, an apparently decreased maximum width of tooth. Evidence: TAS. Frequency: Very frequent (HP:0040281). (ORPHA:1515)
- Narrow chest (HP:0000774): Reduced width of the chest from side to side, associated with a reduced distance from the sternal notch to the tip of the shoulder. Evidence: TAS. Frequency: Very frequent (HP:0040281). (ORPHA:1515)
- Osteoporosis (HP:0000939): Osteoporosis is a systemic skeletal disease characterized by low bone density and microarchitectural deterioration of bone tissue with a consequent increase in bone fragility. According to the WHO criteria, osteoporosis is defined as a BMD that lies 2.5 standard deviations or more below the average value for young healthy adults (a T-score below -2.5 SD). Evidence: TAS. Frequency: Very frequent (HP:0040281). (ORPHA:1515)
- Abnormal diaphysis morphology (HP:0000940): An abnormality of the structure or form of the diaphysis, i.e., of the main or mid-section (shaft) of a long bone. Evidence: TAS. Frequency: Very frequent (HP:0040281). (ORPHA:1515)
- Abnormal metaphysis morphology (HP:0000944): An abnormality of one or more metaphysis, i.e., of the somewhat wider portion of a long bone that is adjacent to the epiphyseal growth plate and grows during childhood. Evidence: TAS. Frequency: Very frequent (HP:0040281). (ORPHA:1515)
- Brachydactyly (HP:0001156): Digits that appear disproportionately short compared to the hand/foot. The word brachydactyly is used here to describe a series distinct patterns of shortened digits (brachydactyly types A-E). This is the sense used here. Evidence: TAS. Frequency: Very frequent (HP:0040281). (ORPHA:1515)
- Abnormal fingernail morphology (HP:0001231): An abnormality of the fingernails. Evidence: TAS. Frequency: Very frequent (HP:0040281). (ORPHA:1515)
- Frontal bossing (HP:0002007): Bilateral bulging of the lateral frontal bone prominences with relative sparing of the midline. Evidence: TAS. Frequency: Very frequent (HP:0040281). (ORPHA:1515)
- Sparse hair (HP:0008070): Reduced density of hairs. Evidence: TAS. Frequency: Very frequent (HP:0040281). (ORPHA:1515)
- Abnormal toenail morphology (HP:0008388): An anomaly of the toenail. Evidence: TAS. Frequency: Very frequent (HP:0040281). (ORPHA:1515)